- Congenital onset (HP:0003577): A phenotypic abnormality that is present at birth. Evidence: PCS. Frequency: 13/13. (PMID:16459341)
- Abnormal vestibular function (HP:0001751): An abnormality of the functioning of the vestibular apparatus. Evidence: PCS. Frequency: 0/13. (PMID:16459341)
- Bilateral sensorineural hearing impairment (HP:0008619): A form of sensorineural hearing impairment that affects both ears. Evidence: PCS. Onset: Infantile onset (HP:0003593). (PMID:16752389)
- Sensorineural hearing impairment (HP:0000407): A type of hearing impairment in one or both ears related to an abnormal functionality of the cochlear nerve. Evidence: PCS. Frequency: 13/13. Onset: Congenital onset (HP:0003577). (PMID:16459341)
- Abnormal fundus morphology (HP:0001098): Any structural abnormality of the fundus of the eye. Evidence: PCS. Frequency: 0/13. (PMID:16459341)
- Autosomal recessive inheritance (HP:0000007): A mode of inheritance that is observed for traits related to a gene encoded on one of the autosomes (i.e., the human chromosomes 1-22) in which a trait manifests in individuals with two pathogenic alleles, either homozygotes (two copies of the same mutant allele) or compound heterozygotes (whereby each copy of a gene has a distinct mutant allele). Evidence: PCS. (PMID:16459341)
These phenotypes are associated with the disease autosomal recessive nonsyndromic hearing loss 67 (OMIM:610265).